- Sensorineural hearing impairment (HP:0000407): A type of hearing impairment in one or both ears related to an abnormal functionality of the cochlear nerve. Evidence: PCS. (PMID:12634859)
- Autosomal dominant inheritance (HP:0000006): A mode of inheritance that is observed for traits related to a gene encoded on one of the autosomes (i.e., the human chromosomes 1-22) in which a trait manifests in heterozygotes. In the context of medical genetics, an autosomal dominant disorder is caused when a single copy of the mutant allele is present. Males and females are affected equally, and can both transmit the disorder with a risk of 50% for each child of inheriting the mutant allele. Evidence: PCS. (PMID:12634859)
These phenotypes are associated with the disease autosomal dominant nonsyndromic hearing loss 47 (OMIM:608652).